Phenotypes associated with the disease Narcolepsy type 1 (ORPHA:2073):
- Attention deficit hyperactivity disorder (HP:0007018): Attention deficit hyperactivity disorder (ADHD) manifests at age 2-3 years or by first grade at the latest. The main symptoms are distractibility, impulsivity, hyperactivity, and often trouble organizing tasks and projects, difficulty going to sleep, and social problems from being aggressive, loud, or impatient. Evidence: TAS. Frequency: Frequent (HP:0040282). (ORPHA:2073)
- Abnormal pupillary function (HP:0007686): A functional abnormality of the pupil. Evidence: TAS. Frequency: Frequent (HP:0040282). (ORPHA:2073)
- Restless legs (HP:0012452): An irresistible urge to move the legs, usually accompanied by unpleasant sensations deep within the limbs. Symptoms typically begin or worsen during periods of rest or inactivity, are most pronounced in the evening or at night, and are temporarily relieved by movement such as walking or stretching. The disturbance often interferes with the initiation or maintenance of sleep. Evidence: TAS. Frequency: Frequent (HP:0040282). (ORPHA:2073)
- NREM parasomnia (HP:0025235): A parasomnia that occurs during non-rapid eye movement (NREM) sleep. Evidence: TAS. Frequency: Frequent (HP:0040282). (ORPHA:2073)
- Female sexual dysfunction (HP:0030014): A problem occurring during any phase of the female sexual response cycle that prevents the individual from experiencing satisfaction from the sexual activity. Evidence: TAS. Frequency: Frequent (HP:0040282). (ORPHA:2073)
- Male sexual dysfunction (HP:0040307): A problem occurring during any phase of the male sexual response cycle that prevents the individual from experiencing satisfaction from the sexual activity. Evidence: TAS. Frequency: Frequent (HP:0040282). (ORPHA:2073)
- Restlessness (HP:0000711): A state of unease is characterized by diffuse motor activity or motion, which is subject to limited control, nonproductive, or disorganized behavior. Evidence: TAS. Frequency: Occasional (HP:0040283). (ORPHA:2073)
- Depression (HP:0000716): Frequently experiencing feelings of being down, miserable, and/or hopeless; struggling to recover from these moods; having a pessimistic outlook on the future; feeling a pervasive sense of shame; having a low self-worth; experiencing thoughts of suicide and engaging in suicidal behavior. Evidence: TAS. Frequency: Occasional (HP:0040283). (ORPHA:2073)
- Precocious puberty (HP:0000826): The onset of secondary sexual characteristics before a normal age. Although it is difficult to define normal age ranges because of the marked variation with which puberty begins in normal children, precocious puberty can be defined as the onset of puberty before the age of 8 years in girls or 9 years in boys. Evidence: TAS. Frequency: Occasional (HP:0040283). (ORPHA:2073)
- Syncope (HP:0001279): A transient loss of consciousness (i.e., characterized by a rapid onset, a short duration, and a spontaneous and complete recovery) due to cerebral hypoperfusion. Evidence: TAS. Frequency: Occasional (HP:0040283). (ORPHA:2073)
- Slurred speech (HP:0001350): Abnormal coordination of muscles involved in speech. Evidence: TAS. Frequency: Occasional (HP:0040283). (ORPHA:2073)
- Hallucinations (HP:0000738): Perceptions in a conscious and awake state that, in the absence of external stimuli, have qualities of real perception. These perceptions are vivid, substantial, and located in external objective space. Evidence: TAS. Frequency: Very frequent (HP:0040281). (ORPHA:2073)
- Excessive daytime somnolence (HP:0001262): A state of abnormally strong desire for sleep during the daytime. Evidence: TAS. Frequency: Very frequent (HP:0040281). (ORPHA:2073)
- Sleep disturbance (HP:0002360): An abnormal pattern in the quality, quantity, or characteristics of sleep. Evidence: TAS. Frequency: Very frequent (HP:0040281). (ORPHA:2073)
- Cataplexy (HP:0002524): A sudden and transient episode of bilateral loss of muscle tone, often triggered by emotions. Evidence: TAS. Frequency: Very frequent (HP:0040281). (ORPHA:2073)
- Transient global amnesia (HP:0010534): A paroxysmal, transient loss of memory function with preservation of immediate recall and remote memory but with a severe impairment of memory for recent events and ability to retain new information. Evidence: TAS. Frequency: Very frequent (HP:0040281). (ORPHA:2073)
- Nocturia (HP:0000017): Abnormally increased production of urine during the night leading to an unusually frequent need to urinate. Evidence: TAS. Frequency: Frequent (HP:0040282). (ORPHA:2073)
- Anxiety (HP:0000739): Intense feelings of nervousness, tension, or panic often arise in response to interpersonal stresses. There is worry about the negative effects of past unpleasant experiences and future negative possibilities. Individuals may feel fearful, apprehensive, or threatened by uncertainty, and they may also have fears of falling apart or losing control. Evidence: TAS. Frequency: Frequent (HP:0040282). (ORPHA:2073)
- Hypertension (HP:0000822): The presence of chronic increased pressure in the systemic arterial system. Evidence: TAS. Frequency: Frequent (HP:0040282). (ORPHA:2073)
- Hyperhidrosis (HP:0000975): Abnormal excessive perspiration (sweating) despite the lack of appropriate stimuli like hot and humid weather. Evidence: TAS. Frequency: Frequent (HP:0040282). (ORPHA:2073)
- Constipation (HP:0002019): Infrequent or difficult evacuation of feces. Evidence: TAS. Frequency: Frequent (HP:0040282). (ORPHA:2073)
- Drooling (HP:0002307): Habitual flow of saliva out of the mouth. Evidence: TAS. Frequency: Frequent (HP:0040282). (ORPHA:2073)
- Abnormal rapid eye movement sleep (HP:0002494): Abnormality of REM Sleep are phases of REM sleep are characterized by desynchronized EEG patterns, increases in heart rate and blood pressure, sympathetic activation, and a profound loss of muscle tone except for the eye and middle-ear muscles. There are also phases of rapid eye movements. Evidence: TAS. Frequency: Frequent (HP:0040282). (ORPHA:2073)
- Hypnagogic hallucination (HP:0002519): Hypnagogic hallucinations are brief hallucinations that occur when falling asleep. Evidence: TAS. Frequency: Frequent (HP:0040282). (ORPHA:2073)
- Hypnopompic hallucination (HP:0006896): Hallucinations occurring during the transition from sleep to wakefulness. Evidence: TAS. Frequency: Frequent (HP:0040282). (ORPHA:2073)
- Obesity (HP:0001513): Accumulation of substantial excess body fat. Evidence: TAS. Frequency: Occasional (HP:0040283). (ORPHA:2073)
- Migraine (HP:0002076): Migraine is a chronic neurological disorder characterized by episodic attacks of headache and associated symptoms. Evidence: TAS. Frequency: Occasional (HP:0040283). (ORPHA:2073)
- Sleep apnea (HP:0010535): An intermittent cessation of airflow at the mouth and nose during sleep is known as sleep apnea. Apneas that last at least 10 seconds are considered significant, but individuals with sleep apnea may experience apneas lasting from 20 seconds up to 2 or 3 minutes. Patients may have up to 15 events per hour of sleep. Evidence: TAS. Frequency: Occasional (HP:0040283). (ORPHA:2073)
- Sleep paralysis (HP:0025233): Inability to move trunk and limbs and inability to speak during transition into or out of sleep; awareness is preserved and recall is present. Evidence: TAS. Frequency: Occasional (HP:0040283). (ORPHA:2073)
- Psychosis (HP:0000709): A condition characterized by changes in personality and thought patterns, often accompanied by hallucinations and delusional beliefs, is known as psychosis. Evidence: TAS. Frequency: Very rare (HP:0040284). (ORPHA:2073)